- Delayed epiphyseal ossification (HP:0002663). Evidence: PCS. (PMID:31263216)
- Spicular pigmentation of the retina (HP:0007737): Pigment migration into the retina in a bone-spicule configuration (resembling the nucleated cells within the lacuna of bone). Evidence: PCS. (PMID:31263216)
- Retinal pigment epithelial mottling (HP:0007814): Mottling (spots or blotches of different shades) of the retinal pigment epithelium, i.e., localized or generalized fundus pigment granularity associated with processes at the level of the retinal pigment epithelium. Evidence: PCS. (PMID:31263216)
- Microcephaly (HP:0000252): Head circumference below 2 standard deviations below the mean for age and gender. Evidence: PCS. (PMID:31263216)
- Scoliosis (HP:0002650): The presence of an abnormal lateral curvature of the spine. Evidence: PCS. (PMID:31263216)
- Short stature (HP:0004322): A height below that which is expected according to age and gender norms. Although there is no universally accepted definition of short stature, many refer to "short stature" as height more than 2 standard deviations below the mean for age and gender (or below the 3rd percentile for age and gender dependent norms). Evidence: PCS. (PMID:31263216)
- Global developmental delay (HP:0001263): A delay in the achievement of motor or mental milestones in the domains of development of a child, including motor skills, speech and language, cognitive skills, and social and emotional skills. This term should only be used to describe children younger than five years of age. Evidence: PCS. (PMID:31263216)
- Metaphyseal striations (HP:0031367): Longitudinal densities on radiographs located in a metaphysis (the narrow region of a long bone between the epiphysis and the diaphysis). Evidence: PCS. (PMID:31263216)
- Sensorineural hearing impairment (HP:0000407): A type of hearing impairment in one or both ears related to an abnormal functionality of the cochlear nerve. Evidence: PCS. (PMID:31263216)
- Autosomal recessive inheritance (HP:0000007): A mode of inheritance that is observed for traits related to a gene encoded on one of the autosomes (i.e., the human chromosomes 1-22) in which a trait manifests in individuals with two pathogenic alleles, either homozygotes (two copies of the same mutant allele) or compound heterozygotes (whereby each copy of a gene has a distinct mutant allele). Evidence: PCS. (PMID:31263216)
- Retinal degeneration (HP:0000546): A nonspecific term denoting progressive loss of the retinal pigment epithelium (RPE) and/or neurosensory retinal cells. Evidence: PCS. (PMID:31263216)
- Optic disc pallor (HP:0000543): A pale yellow discoloration of the optic disc (the area of the optic nerve head in the retina). The optic disc normally has a pinkish hue with a central yellowish depression. Evidence: PCS. (PMID:31263216)
- Intellectual disability (HP:0001249): The term intellectual disability or intellectual developmental disorder is used to describe significantly sub-average intellectual and adaptive functioning based on clinical assessment and as measured by individually administered, appropriately normed, standardized and validated tests of intellectual functioning and adaptive behavior, with onset during the developmental period from infancy through adolescence. Evidence: PCS. (PMID:31263216)
These phenotypes are associated with the disease Liberfarb syndrome (OMIM:618889).